Phenotypes associated with the disease cone-rod synaptic disorder, congenital nonprogressive (OMIM:610427):
- Strabismus (HP:0000486): A misalignment of the eyes so that the visual axes deviate from bifoveal fixation. The classification of strabismus may be based on a number of features including the relative position of the eyes, whether the deviation is latent or manifest, intermittent or constant, concomitant or otherwise and according to the age of onset and the relevance of any associated refractive error. Evidence: TAS. Frequency: Occasional (HP:0040283). (OMIM:610427)
- Color vision defect (HP:0000551): An anomaly in the ability to discriminate between or recognize colors. Evidence: TAS. Frequency: Occasional (HP:0040283). (OMIM:610427)
- Nystagmus (HP:0000639): Rhythmic, involuntary oscillations of one or both eyes related to abnormality in fixation, conjugate gaze, or vestibular mechanisms. Evidence: PCS. (PMID:16960802)
- Photophobia (HP:0000613): Excessive sensitivity to light with the sensation of discomfort or pain in the eyes due to exposure to bright light. Evidence: TAS. (OMIM:610427)
- Autosomal recessive inheritance (HP:0000007): A mode of inheritance that is observed for traits related to a gene encoded on one of the autosomes (i.e., the human chromosomes 1-22) in which a trait manifests in individuals with two pathogenic alleles, either homozygotes (two copies of the same mutant allele) or compound heterozygotes (whereby each copy of a gene has a distinct mutant allele). Evidence: PCS. (PMID:16960802)
- Early-onset non-progressive night blindness (HP:0007642): A usually nonprogressive (i.e., stationary) form of night blindness with early (presumed to be congenital) onset. Evidence: PCS. (PMID:16960802)
- Visual impairment (HP:0000505): Visual impairment (or vision impairment) is vision loss (of a person) to such a degree as to qualify as an additional support need through a significant limitation of visual capability resulting from either disease, trauma, or congenital or degenerative conditions that cannot be corrected by conventional means, such as refractive correction, medication, or surgery. Evidence: PCS. (PMID:16960802)
- ERG: Reduced dark-adapted b-wave amplitude (HP:0007984): A dark-adapted bright flash electroretinogram in which the b-wave that is of markedly lower amplitude than the associated a-wave. Evidence: PCS. (PMID:16960802)